Phenotypes associated with the disease hearing loss, X-linked 4 (OMIM:300066):
- High-frequency hearing impairment (HP:0005101): A type of hearing impairment affecting primarily the higher frequencies of sound (3,000 to 6,000 Hz). Evidence: TAS. (OMIM:300066)
- Sensorineural hearing impairment (HP:0000407): A type of hearing impairment in one or both ears related to an abnormal functionality of the cochlear nerve. Evidence: TAS. (OMIM:300066)
- Childhood onset (HP:0011463): Onset of disease at the age of between 1 and 5 years. Evidence: TAS. (OMIM:300066)
- X-linked dominant inheritance (HP:0001423): A mode of inheritance that is observed for dominant traits related to a gene encoded on the X chromosome. In the context of medical genetics, X-linked dominant disorders tend to manifest very severely in affected males. The severity of manifestation in females may depend on the degree of skewed X inactivation. Evidence: TAS. (OMIM:300066)